Phenotypes associated with the disease Pa polymorphism of alpha-2-globulin (OMIM:260100):
- Autosomal recessive inheritance (HP:0000007): A mode of inheritance that is observed for traits related to a gene encoded on one of the autosomes (i.e., the human chromosomes 1-22) in which a trait manifests in individuals with two pathogenic alleles, either homozygotes (two copies of the same mutant allele) or compound heterozygotes (whereby each copy of a gene has a distinct mutant allele). Evidence: TAS. (OMIM:260100)
- Abnormal circulating immunoglobulin concentration (HP:0010701): An abnormal deviation from normal levels of immunoglobulins in blood. Evidence: IEA. (OMIM:260100)